- Stage 5 chronic kidney disease (HP:0003774): A degree of kidney failure severe enough to require dialysis or kidney transplantation for survival characterized by a severe reduction in glomerular filtration rate (less than 15 ml/min/1.73 m2) and other manifestations including increased serum creatinine. Evidence: PCS. Frequency: 1/14. (PMID:31513549)
- Multiple glomerular cysts (HP:0100611): The presence of many cysts in the glomerulus of the kidney related to dilatation of the Bowman's capsule. Evidence: PCS. Frequency: 1/14. (PMID:31513549)
- Fetal megacystis (HP:0010956): Fetal megacystis is an abnormally enlarged bladder identified at any gestational age. Evidence: PCS. Frequency: 13/14. Onset: Fetal onset (HP:0011461). (PMID:31513549)
- Ventricular septal defect (HP:0001629): A hole between the two bottom chambers (ventricles) of the heart. The defect is centered around the most superior aspect of the ventricular septum. Evidence: PCS. Frequency: 2/14. (PMID:31513549)
- Hyperechogenic kidneys (HP:0004719): An increase in amplitude of waves returned in ultrasonography of the kidney, which is generally displayed as increased brightness of the signal. Evidence: PCS. Frequency: 2/14. (PMID:31513549)
- Bicuspid aortic valve (HP:0001647): The presence of an aortic valve with two instead of the normal three cusps (flaps). Bicuspid aortic valvue is a malformation of a commissure (small space between the attachment of each cusp to the aortic wall) and the adjacent parts of the two corresponding cusps forming a raphe (the fused area of the two underdeveloped cusps turning into a malformed commissure between both cusps; the raphe is a fibrous ridge that extends from the commissure to the free edge of the two underdeveloped, conjoint cusps). Evidence: PCS. Frequency: 1/14. (PMID:31513549)
- Left ventricular noncompaction cardiomyopathy (HP:0011664): Left ventricular non-compaction (LVNC) is characterized by prominent left ventricular trabeculae and deep inter-trabecular recesses. The myocardial wall is often thickened with a thin, compacted epicardial layer and a thickened endocardial layer. In some patients, LVNC is associated with left ventricular dilatation and systolic dysfunction, which can be transient in neonates. Evidence: PCS. Frequency: 1/14. (PMID:31513549)
- Patent ductus arteriosus (HP:0001643): In utero, the ductus arteriosus (DA) serves to divert ventricular output away from the lungs and toward the placenta by connecting the main pulmonary artery to the descending aorta. A patent ductus arteriosus (PDA) in the first 3 days of life is a physiologic shunt in healthy term and preterm newborn infants, and normally is substantially closed within about 24 hours after bith and completely closed after about three weeks. Failure of physiologcal closure is referred to a persistent or patent ductus arteriosus (PDA). Depending on the degree of left-to-right shunting, PDA can have clinical consequences. Evidence: PCS. Frequency: 1/14. (PMID:31513549)
- Atrial septal defect (HP:0001631): Atrial septal defect (ASD) is a congenital abnormality of the interatrial septum that enables blood flow between the left and right atria via the interatrial septum. Evidence: PCS. Frequency: 1/14. (PMID:31513549)
- Autosomal dominant inheritance (HP:0000006): A mode of inheritance that is observed for traits related to a gene encoded on one of the autosomes (i.e., the human chromosomes 1-22) in which a trait manifests in heterozygotes. In the context of medical genetics, an autosomal dominant disorder is caused when a single copy of the mutant allele is present. Males and females are affected equally, and can both transmit the disorder with a risk of 50% for each child of inheriting the mutant allele. Evidence: TAS. (PMID:31513549)
These phenotypes are associated with the disease megabladder, congenital (OMIM:618719).